Phenotypes associated with the disease Neutropenia-monocytopenia-deafness syndrome (ORPHA:2690):
- Sensorineural hearing impairment (HP:0000407): A type of hearing impairment in one or both ears related to an abnormal functionality of the cochlear nerve. Evidence: TAS. Frequency: Very frequent (HP:0040281). (ORPHA:2690)
- Abnormality of neutrophils (HP:0001874): A neutrophil abnormality. Evidence: TAS. Frequency: Very frequent (HP:0040281). (ORPHA:2690)
- Abnormal macrophage morphology (HP:0004311): An abnormality of macrophages. Evidence: TAS. Frequency: Very frequent (HP:0040281). (ORPHA:2690)
- Abnormality of immune system physiology (HP:0010978): A functional abnormality of the immune system. Evidence: TAS. Frequency: Frequent (HP:0040282). (ORPHA:2690)